Phenotypes associated with the disease tongue, pigmented fungiform papillae of (OMIM:275250):
- Autosomal recessive inheritance (HP:0000007): A mode of inheritance that is observed for traits related to a gene encoded on one of the autosomes (i.e., the human chromosomes 1-22) in which a trait manifests in individuals with two pathogenic alleles, either homozygotes (two copies of the same mutant allele) or compound heterozygotes (whereby each copy of a gene has a distinct mutant allele). Evidence: IEA. (OMIM:275250)
- Abnormality of the tongue (HP:0000157): Any abnormality of the tongue. Evidence: IEA. (OMIM:275250)